Phenotypes associated with the disease Primary non-essential cutis verticis gyrata (ORPHA:357225):
- Cutis gyrata of scalp (HP:0010541): The presence of convoluted folds and furrows formed from thickened skin of the scalp, resembling cerebriform pattern. The scalp has convoluted and elevated folds, 1 to 2 cm in thickness. The convolutions generally cannot be flattened by traction. Evidence: TAS. Frequency: Very frequent (HP:0040281). (ORPHA:357225)
- Abnormal forehead morphology (HP:0000290): An anomaly of the forehead. Evidence: TAS. Frequency: Frequent (HP:0040282). (ORPHA:357225)
- Developmental cataract (HP:0000519): A cataract that occurs congenitally as the result of a developmental defect, in contrast to the majority of cataracts that occur in adulthood as the result of degenerative changes of the lens. Evidence: TAS. Frequency: Frequent (HP:0040282). (ORPHA:357225)
- Seizure (HP:0001250): A seizure is an intermittent abnormality of nervous system physiology characterized by a transient occurrence of signs and/or symptoms due to abnormal excessive or synchronous neuronal activity in the brain. Evidence: TAS. Frequency: Frequent (HP:0040282). (ORPHA:357225)
- Global developmental delay (HP:0001263): A delay in the achievement of motor or mental milestones in the domains of development of a child, including motor skills, speech and language, cognitive skills, and social and emotional skills. This term should only be used to describe children younger than five years of age. Evidence: TAS. Frequency: Frequent (HP:0040282). (ORPHA:357225)
- Gliosis (HP:0002171): Gliosis is the focal proliferation of glial cells in the central nervous system. Evidence: TAS. Frequency: Frequent (HP:0040282). (ORPHA:357225)
- Borderline intellectual disability (HP:0006889): Borderline intellectual disability is defined as an intelligence quotient (IQ) in the range of 70-85. Evidence: TAS. Frequency: Frequent (HP:0040282). (ORPHA:357225)
- Periventricular leukomalacia (HP:0006970): Periventricular leukomalacia is characterized by diffuse injury of deep cerebral white matter, accompanied in its most severe form by focal necrosis. The neuropathologic hallmarks of PVL are microglial activation and focal and diffuse periventricular depletion of premyelinating oligodendroglia. Evidence: TAS. Frequency: Frequent (HP:0040282). (ORPHA:357225)
- Abnormality of pattern visual evoked potentials (HP:0030455). Evidence: TAS. Frequency: Frequent (HP:0040282). (ORPHA:357225)
- Microcephaly (HP:0000252): Head circumference below 2 standard deviations below the mean for age and gender. Evidence: TAS. Frequency: Occasional (HP:0040283). (ORPHA:357225)
- Encephalopathy (HP:0001298): Encephalopathy is a term that means brain disease, damage, or malfunction. In general, encephalopathy is manifested by an altered mental state. Evidence: TAS. Frequency: Occasional (HP:0040283). (ORPHA:357225)
- Ventricular septal defect (HP:0001629): A hole between the two bottom chambers (ventricles) of the heart. The defect is centered around the most superior aspect of the ventricular septum. Evidence: TAS. Frequency: Occasional (HP:0040283). (ORPHA:357225)
- Atrial septal defect (HP:0001631): Atrial septal defect (ASD) is a congenital abnormality of the interatrial septum that enables blood flow between the left and right atria via the interatrial septum. Evidence: TAS. Frequency: Occasional (HP:0040283). (ORPHA:357225)
- Scoliosis (HP:0002650): The presence of an abnormal lateral curvature of the spine. Evidence: TAS. Frequency: Occasional (HP:0040283). (ORPHA:357225)
- Reduced visual acuity (HP:0007663). Evidence: TAS. Frequency: Occasional (HP:0040283). (ORPHA:357225)
- Keloids (HP:0010562). Evidence: TAS. Frequency: Occasional (HP:0040283). (ORPHA:357225)